Phenotypes associated with the disease autosomal recessive nonsyndromic hearing loss 6 (OMIM:600971):
- Congenital onset (HP:0003577): A phenotypic abnormality that is present at birth. Evidence: PCS. (PMID:12145746)
- Hearing impairment (HP:0000365): A decreased magnitude of the sensory perception of sound. Evidence: PCS. Frequency: 15/15. Onset: Congenital onset (HP:0003577). (PMID:12145746)
- Autosomal recessive inheritance (HP:0000007): A mode of inheritance that is observed for traits related to a gene encoded on one of the autosomes (i.e., the human chromosomes 1-22) in which a trait manifests in individuals with two pathogenic alleles, either homozygotes (two copies of the same mutant allele) or compound heterozygotes (whereby each copy of a gene has a distinct mutant allele). Evidence: PCS. (PMID:12145746)